- Stage 5 chronic kidney disease (HP:0003774): A degree of kidney failure severe enough to require dialysis or kidney transplantation for survival characterized by a severe reduction in glomerular filtration rate (less than 15 ml/min/1.73 m2) and other manifestations including increased serum creatinine. Evidence: TAS. (OMIM:161900)
- Progressive (HP:0003676): Applies to a disease manifestation that increases in scope or severity over the course of time, i.e., that worsens with age. Evidence: TAS. (OMIM:161900)
- Nephritis (HP:0000123): The presence of inflammation affecting the kidney. Evidence: IEA. (OMIM:161900)
- Renal insufficiency (HP:0000083): A reduction in the level of performance of the kidneys in areas of function comprising the concentration of urine, removal of wastes, the maintenance of electrolyte balance, homeostasis of blood pressure, and calcium metabolism. Evidence: IEA. (OMIM:161900)
- Microscopic hematuria (HP:0002907): Microscopic hematuria detected by dipstick or microscopic examination of the urine. Evidence: IEA. (OMIM:161900)
- Adult onset (HP:0003581): Onset of disease manifestations in adulthood, defined here as at the age of 16 years or later. Evidence: IEA. (OMIM:161900)
- Hypertension (HP:0000822): The presence of chronic increased pressure in the systemic arterial system. Evidence: IEA. (OMIM:161900)
- Proteinuria (HP:0000093): Increased levels of protein in the urine. Evidence: IEA. (OMIM:161900)
- Autosomal dominant inheritance (HP:0000006): A mode of inheritance that is observed for traits related to a gene encoded on one of the autosomes (i.e., the human chromosomes 1-22) in which a trait manifests in heterozygotes. In the context of medical genetics, an autosomal dominant disorder is caused when a single copy of the mutant allele is present. Males and females are affected equally, and can both transmit the disorder with a risk of 50% for each child of inheriting the mutant allele. Evidence: IEA. (OMIM:161900)
- Elevated circulating creatinine concentration (HP:0003259): An increased amount of creatinine in the blood. Evidence: TAS. (OMIM:161900)
These phenotypes are associated with the disease autosomal dominant progressive nephropathy with hypertension (OMIM:161900).